- Recurrent corneal erosions (HP:0000495): The presence of recurrent corneal epithelial erosions. Although most corneal epithelial defects heal quickly, some may show recurrent ulcerations. Evidence: IEA. (OMIM:148800)
- Craniosynostosis (HP:0001363): Craniosynostosis refers to the premature closure of the cranial sutures. Primary craniosynostosis refers to the closure of one or more sutures due to abnormalities in skull development, and secondary craniosynostosis results from failure of brain growth. Evidence: IEA. (OMIM:148800)
- Hydrocephalus (HP:0000238): Hydrocephalus is an active distension of the ventricular system of the brain resulting from inadequate passage of CSF from its point of production within the cerebral ventricles to its point of absorption into the systemic circulation. Evidence: IEA. (OMIM:148800)
- Sporadic (HP:0003745): Cases of the disease in question occur without a previous family history, i.e., as isolated cases without being transmitted from a parent and without other siblings being affected. Evidence: IEA. (OMIM:148800)
- Proptosis (HP:0000520): An eye that is protruding anterior to the plane of the face to a greater extent than is typical. Evidence: IEA. (OMIM:148800)
- Elbow ankylosis (HP:0003070). Evidence: IEA. (OMIM:148800)
- Autosomal dominant inheritance (HP:0000006): A mode of inheritance that is observed for traits related to a gene encoded on one of the autosomes (i.e., the human chromosomes 1-22) in which a trait manifests in heterozygotes. In the context of medical genetics, an autosomal dominant disorder is caused when a single copy of the mutant allele is present. Males and females are affected equally, and can both transmit the disorder with a risk of 50% for each child of inheriting the mutant allele. Evidence: IEA. (OMIM:148800)
- Cloverleaf skull (HP:0002676): Trilobar skull configuration when viewed from the front or behind. Evidence: IEA. (OMIM:148800)
These phenotypes are associated with the disease isolated cloverleaf skull syndrome (OMIM:148800).